Phenotypes associated with the disease Vaginal atresia (ORPHA:65681, an Orphanet rare-disease identifier):
- Vaginal atresia (HP:0000148, a Human Phenotype Ontology term): Congenital occlusion of the vagina or adhesion of the walls of the vagina causing occlusion. Evidence: TAS. Frequency: Obligate (HP:0040280, a Human Phenotype Ontology term). (ORPHA:65681)
- Abnormality of the uterus (HP:0000130, a Human Phenotype Ontology term): An abnormality of the uterus. Evidence: TAS. Frequency: Frequent (HP:0040282, a Human Phenotype Ontology term). (ORPHA:65681)
- Primary amenorrhea (HP:0000786, a Human Phenotype Ontology term). Evidence: TAS. Frequency: Frequent (HP:0040282, a Human Phenotype Ontology term). (ORPHA:65681)
- Abdominal pain (HP:0002027, a Human Phenotype Ontology term): An unpleasant sensation characterized by physical discomfort (such as pricking, throbbing, or aching) and perceived to originate in the abdomen. Evidence: TAS. Frequency: Frequent (HP:0040282, a Human Phenotype Ontology term). (ORPHA:65681)
- Imperforate hymen (HP:0030011, a Human Phenotype Ontology term): A congenital disorder where the hymen (a membrane that surrounds or partially covers the external vaginal opening) does not have an opening and completely obstructs the vagina. Evidence: TAS. Frequency: Frequent (HP:0040282, a Human Phenotype Ontology term). (ORPHA:65681)
- Abdominal mass (HP:0031500, a Human Phenotype Ontology term): An abnormal enlargement or swelling in the abdomen. Evidence: TAS. Frequency: Frequent (HP:0040282, a Human Phenotype Ontology term). (ORPHA:65681)
- Pelvic mass (HP:0031501, a Human Phenotype Ontology term): An abnormal enlargement or swelling in the pelvic region. Evidence: TAS. Frequency: Frequent (HP:0040282, a Human Phenotype Ontology term). (ORPHA:65681)
- Uterus didelphys (HP:0003762, a Human Phenotype Ontology term): A malformation of the uterus in which the uterus is present as a paired organ as a result of the failure of fusion of the mullerian ducts during embryogenesis. Evidence: TAS. Frequency: Occasional (HP:0040283, a Human Phenotype Ontology term). (ORPHA:65681)
- Cervicitis (HP:0030160, a Human Phenotype Ontology term): Inflammation of the uterine cervix. Evidence: TAS. Frequency: Occasional (HP:0040283, a Human Phenotype Ontology term). (ORPHA:65681)
- Vaginal hematocele (HP:0100674, a Human Phenotype Ontology term). Evidence: TAS. Frequency: Occasional (HP:0040283, a Human Phenotype Ontology term). (ORPHA:65681)
- Transverse vaginal septum (HP:0000145, a Human Phenotype Ontology term). Evidence: TAS. Frequency: Very rare (HP:0040284, a Human Phenotype Ontology term). (ORPHA:65681)
- Bicornuate uterus (HP:0000813, a Human Phenotype Ontology term): The presence of a bicornuate uterus. Evidence: TAS. Frequency: Very rare (HP:0040284, a Human Phenotype Ontology term). (ORPHA:65681)